- Leber optic atrophy (HP:0001112): Degeneration of retinal ganglion cells and their axons. Evidence: IEA. (OMIM:308905)
- Optic atrophy (HP:0000648): Atrophy of the optic nerve. Optic atrophy results from the death of the retinal ganglion cell axons that comprise the optic nerve and manifesting as a pale optic nerve on fundoscopy. Evidence: IEA. (OMIM:308905)
- X-linked inheritance (HP:0001417): A mode of inheritance that is observed for traits related to a gene encoded on the X chromosome. Evidence: IEA. (OMIM:308905)
These phenotypes are associated with the disease Leber optic atrophy, susceptibility to (OMIM:308905).